Phenotypes associated with the disease X-linked retinal dysplasia (OMIM:312550):
- Falciform retinal fold (HP:0001493): An area of the retina that is buckled so that a sector-shaped sheet of retina lies in front of the normal retina. This feature is of congenital onset. Evidence: IEA. (OMIM:312550)
- X-linked inheritance (HP:0001417): A mode of inheritance that is observed for traits related to a gene encoded on the X chromosome. Evidence: IEA. (OMIM:312550)
- Retinal dysplasia (HP:0007973): Abnormal growth and differentiation, structure and appearance of the retina present from birth. Evidence: IEA. (OMIM:312550)